Phenotypes associated with the disease autosomal dominant nonsyndromic hearing loss 67 (OMIM:616340):
- Sensorineural hearing impairment (HP:0000407): A type of hearing impairment in one or both ears related to an abnormal functionality of the cochlear nerve. Evidence: TAS. (OMIM:616341)
- Tinnitus (HP:0000360): Tinnitus is an auditory perception that can be described as the experience of sound, in the ear or in the head, in the absence of external acoustic stimulation. Evidence: TAS. (OMIM:616341)
- Autosomal dominant inheritance (HP:0000006): A mode of inheritance that is observed for traits related to a gene encoded on one of the autosomes (i.e., the human chromosomes 1-22) in which a trait manifests in heterozygotes. In the context of medical genetics, an autosomal dominant disorder is caused when a single copy of the mutant allele is present. Males and females are affected equally, and can both transmit the disorder with a risk of 50% for each child of inheriting the mutant allele. Evidence: TAS. (OMIM:616341)